Phenotypes associated with the disease porokeratosis 9, multiple types (OMIM:616631):
- Juvenile onset (HP:0003621): Onset of signs or symptoms of disease between the age of 5 and 15 years. Evidence: PCS. Frequency: 1/4. (PMID:26202976)
- Middle age onset (HP:0003596): A type of adult onset with onset of symptoms at the age of 40 to 60 years. Evidence: PCS. Frequency: 2/4. (PMID:26202976)
- Young adult onset (HP:0011462): Onset of disease at the age of between 16 and 40 years. Evidence: PCS. Frequency: 1/4. (PMID:26202976)
- Porokeratosis (HP:0200044): A clonal disorder of keratinization with one or multiple atrophic patches surrounded by a clinically and histologically distinctive hyperkeratotic ridgelike border called the cornoid lamella. Evidence: PCS. Frequency: 4/4. (PMID:26202976)
- Autosomal dominant inheritance (HP:0000006): A mode of inheritance that is observed for traits related to a gene encoded on one of the autosomes (i.e., the human chromosomes 1-22) in which a trait manifests in heterozygotes. In the context of medical genetics, an autosomal dominant disorder is caused when a single copy of the mutant allele is present. Males and females are affected equally, and can both transmit the disorder with a risk of 50% for each child of inheriting the mutant allele. Evidence: PCS. (PMID:26202976)